- Natal tooth (HP:0000695): A tooth present at birth or erupting within the first month of life. Evidence: IEA. (OMIM:184510)
- Abnormal nail morphology (HP:0001597): Abnormal structure or appearance of the nail. Evidence: IEA. (OMIM:184510)
- Steatocystoma multiplex (HP:0012035): Multiple, localized or widespread, asymptomatic or inflammatory dermal cysts involving the pilosebaceous units. Lesions can appear anywhere on the body, but steatocystoma multiplex is more commonly involved with those areas of the skin with a high density of developed pilosebaceous units (e.g., the axilla, groin, neck, and proximal extremities). Evidence: IEA. (OMIM:184510)
- Autosomal dominant inheritance (HP:0000006): A mode of inheritance that is observed for traits related to a gene encoded on one of the autosomes (i.e., the human chromosomes 1-22) in which a trait manifests in heterozygotes. In the context of medical genetics, an autosomal dominant disorder is caused when a single copy of the mutant allele is present. Males and females are affected equally, and can both transmit the disorder with a risk of 50% for each child of inheriting the mutant allele. Evidence: IEA. (OMIM:184510)
These phenotypes are associated with the disease steatocystoma multiplex-natal teeth syndrome (OMIM:184510).